Phenotypes associated with the disease Adrenocortical carcinoma with pure aldosterone hypersecretion (ORPHA:231625):
- Hypertension (HP:0000822): The presence of chronic increased pressure in the systemic arterial system. Evidence: TAS. Frequency: Obligate (HP:0040280). (ORPHA:231625)
- Neoplasm of the adrenal gland (HP:0100631): A tumor (abnormal growth of tissue) of the adrenal gland. Evidence: TAS. Frequency: Obligate (HP:0040280). (ORPHA:231625)
- Muscle weakness (HP:0001324): Reduced strength of muscles. Evidence: TAS. Frequency: Very frequent (HP:0040281). (ORPHA:231625)
- Hypokalemia (HP:0002900): The concentration of potassium(1+) in the blood circulation is below the lower limit of normal. Evidence: TAS. Frequency: Very frequent (HP:0040281). (ORPHA:231625)
- Increased circulating cortisol level (HP:0003118): Overproduction of the hormone of cortisol by the adrenal cortex, resulting in a characteristic combination of clinical symptoms termed Cushing syndrome, with truncal obesity, a round, full face, striae atrophicae and acne, muscle weakness, and other features. Evidence: TAS. Frequency: Very frequent (HP:0040281). (ORPHA:231625)
- Decreased circulating renin concentration (HP:0003351): An decreased level of renin in the blood. Evidence: TAS. Frequency: Very frequent (HP:0040281). (ORPHA:231625)
- Glucocortocoid-insensitive primary hyperaldosteronism (HP:0011740): A form of primary hyperaldosteronism in which the overproduction of aldosterone cannot be suppressed by the administration of dexamethasone or similar glucocorticoids. Evidence: TAS. Frequency: Very frequent (HP:0040281). (ORPHA:231625)
- Metabolic alkalosis (HP:0200114): Metabolic alkalosis is defined as a disease state where the pH is elevated to greater than 7.45 secondary to some metabolic process. Evidence: TAS. Frequency: Very frequent (HP:0040281). (ORPHA:231625)
- Palpitations (HP:0001962): A sensation that the heart is pounding or racing, which is a non-specific sign but may be a manifestation of arrhythmia. Evidence: TAS. Frequency: Frequent (HP:0040282). (ORPHA:231625)
- Nausea (HP:0002018): A sensation of unease in the stomach together with an urge to vomit. Evidence: TAS. Frequency: Frequent (HP:0040282). (ORPHA:231625)
- Increased urinary potassium (HP:0003081): An increased concentration of potassium(1+) in the urine. Evidence: TAS. Frequency: Frequent (HP:0040282). (ORPHA:231625)
- Muscle spasm (HP:0003394): Sudden and involuntary contractions of one or more muscles. Evidence: TAS. Frequency: Frequent (HP:0040282). (ORPHA:231625)
- Paresthesia (HP:0003401): Abnormal sensations such as tingling, pricking, or numbness of the skin with no apparent physical cause. Evidence: TAS. Frequency: Frequent (HP:0040282). (ORPHA:231625)
- Abnormal T-wave (HP:0005135): An abnormality of the T wave on the electrocardiogram, which mainly represents the repolarization of the ventricles. Evidence: TAS. Frequency: Frequent (HP:0040282). (ORPHA:231625)
- Tinnitus (HP:0000360): Tinnitus is an auditory perception that can be described as the experience of sound, in the ear or in the head, in the absence of external acoustic stimulation. Evidence: TAS. Frequency: Occasional (HP:0040283). (ORPHA:231625)
- Epistaxis (HP:0000421): Epistaxis, or nosebleed, refers to a hemorrhage localized in the nose. Evidence: TAS. Frequency: Occasional (HP:0040283). (ORPHA:231625)
- Intracranial hemorrhage (HP:0002170): Hemorrhage occurring within the skull. Evidence: TAS. Frequency: Occasional (HP:0040283). (ORPHA:231625)
- Headache (HP:0002315): Cephalgia, or pain sensed in various parts of the head, not confined to the area of distribution of any nerve. Evidence: TAS. Frequency: Occasional (HP:0040283). (ORPHA:231625)